Phenotypes associated with the disease immunodeficiency 31B (OMIM:613796):
- Recurrent mycobacterial infections (HP:0011274): Increased susceptibility to mycobacterial infections as manifested by recurrent episodes of mycobacterial infection. Evidence: TAS. (OMIM:613796)
- Autosomal recessive inheritance (HP:0000007): A mode of inheritance that is observed for traits related to a gene encoded on one of the autosomes (i.e., the human chromosomes 1-22) in which a trait manifests in individuals with two pathogenic alleles, either homozygotes (two copies of the same mutant allele) or compound heterozygotes (whereby each copy of a gene has a distinct mutant allele). Evidence: TAS. (OMIM:613796)
- Recurrent viral infections (HP:0004429): Increased susceptibility to viral infections as manifested by recurrent episodes of viral infection. Evidence: TAS. (OMIM:613796)
- HSV encephalitis (HP:0012302): Infection of the brain parenchyma with herpes simplex virus, resulting in inflammation of the brain parenchyma with neurologic dysfunction. Evidence: TAS. (OMIM:613796)